- Abnormal metaphysis morphology (HP:0000944): An abnormality of one or more metaphysis, i.e., of the somewhat wider portion of a long bone that is adjacent to the epiphyseal growth plate and grows during childhood. Evidence: TAS. Frequency: Very frequent (HP:0040281). (ORPHA:1040)
- Joint stiffness (HP:0001387): Joint stiffness is a perceived sensation of tightness in a joint or joints when attempting to move them after a period of inactivity. Joint stiffness typically subsides over time. Evidence: TAS. Frequency: Very frequent (HP:0040281). (ORPHA:1040)
- Abnormality of the lower limb (HP:0002814): An abnormality of the leg. Evidence: TAS. Frequency: Very frequent (HP:0040281). (ORPHA:1040)
- Abnormal ulnar metaphysis morphology (HP:0004039): Any structural abnormality of the portion of the ulna between the epiphysis and the diaphysis. Evidence: TAS. Frequency: Very frequent (HP:0040281). (ORPHA:1040)
- Short stature (HP:0004322): A height below that which is expected according to age and gender norms. Although there is no universally accepted definition of short stature, many refer to "short stature" as height more than 2 standard deviations below the mean for age and gender (or below the 3rd percentile for age and gender dependent norms). Evidence: TAS. Frequency: Very frequent (HP:0040281). (ORPHA:1040)
- Abnormal epiphysis morphology (HP:0005930): An anomaly of epiphysis, which is the expanded articular end of a long bone that developes from a secondary ossification center, and which during the period of growth is either entirely cartilaginous or is separated from the shaft by a cartilaginous disk. Evidence: TAS. Frequency: Very frequent (HP:0040281). (ORPHA:1040)
- Bowing of the long bones (HP:0006487): A bending or abnormal curvature of a long bone. Evidence: TAS. Frequency: Very frequent (HP:0040281). (ORPHA:1040)
- Aplasia/Hypoplasia of the radius (HP:0006501): A small/hypoplastic or absent/aplastic radius. Evidence: TAS. Frequency: Very frequent (HP:0040281). (ORPHA:1040)
- Abnormal morphology of ulna (HP:0040071): Any structural anomaly of the ulna, a bone of the forearm the extends from the elbow to the little finger. Evidence: TAS. Frequency: Very frequent (HP:0040281). (ORPHA:1040)
These phenotypes are associated with the disease Metaphyseal anadysplasia (ORPHA:1040).